Phenotypes associated with the disease macular degeneration, X-linked atrophic (OMIM:300834):
- X-linked recessive inheritance (HP:0001419): A mode of inheritance that is observed for recessive traits related to a gene encoded on the X chromosome. In the context of medical genetics, X-linked recessive disorders manifest in males (who have one copy of the X chromosome and are thus hemizygotes), but generally not in female heterozygotes who have one mutant and one normal allele. Evidence: PCS. (PMID:12160730)
- Macular degeneration (HP:0000608): A nonspecific term denoting degeneration of the retinal pigment epithelium and/or retinal photoreceptor cells of the macula lutea. Evidence: PCS. (PMID:12160730)
- Reduced visual acuity (HP:0007663). Evidence: PCS. (PMID:12160730)